Phenotypes associated with the disease phlebectasia of lips (OMIM:171450, an entry in Online Mendelian Inheritance in Man):
- Autosomal dominant inheritance (HP:0000006, a Human Phenotype Ontology term): A mode of inheritance that is observed for traits related to a gene encoded on one of the autosomes (i.e., the human chromosomes 1-22) in which a trait manifests in heterozygotes. In the context of medical genetics, an autosomal dominant disorder is caused when a single copy of the mutant allele is present. Males and females are affected equally, and can both transmit the disorder with a risk of 50% for each child of inheriting the mutant allele. Evidence: IEA. (OMIM:171450)
- Abnormal lip morphology (HP:0000159, a Human Phenotype Ontology term): An abnormality of the lip. Evidence: IEA. (OMIM:171450)